Phenotypes associated with the disease Progeroid syndrome, Petty type (ORPHA:2963):
- Everted lower lip vermilion (HP:0000232): An abnormal configuration of the lower lip such that it is turned outward i.e., everted, with the Inner aspect of the lower lip vermilion (normally opposing the teeth) being visible in a frontal view. Evidence: TAS. Frequency: Very frequent (HP:0040281). (ORPHA:2963)
- Wide anterior fontanel (HP:0000260): Enlargement of the anterior fontanelle with respect to age-dependent norms. Evidence: TAS. Frequency: Very frequent (HP:0040281). (ORPHA:2963)
- Epicanthus (HP:0000286): A fold of skin starting above the medial aspect of the upper eyelid and arching downward to cover, pass in front of and lateral to the medial canthus. Evidence: TAS. Frequency: Very frequent (HP:0040281). (ORPHA:2963)
- Mandibular prognathia (HP:0000303): Abnormal prominence of the chin related to increased length of the mandible. Evidence: TAS. Frequency: Very frequent (HP:0040281). (ORPHA:2963)
- Broad forehead (HP:0000337): Width of the forehead or distance between the frontotemporales is more than two standard deviations above the mean (objective); or apparently increased distance between the two sides of the forehead. Evidence: TAS. Frequency: Very frequent (HP:0040281). (ORPHA:2963)
- Strabismus (HP:0000486): A misalignment of the eyes so that the visual axes deviate from bifoveal fixation. The classification of strabismus may be based on a number of features including the relative position of the eyes, whether the deviation is latent or manifest, intermittent or constant, concomitant or otherwise and according to the age of onset and the relevance of any associated refractive error. Evidence: TAS. Frequency: Very frequent (HP:0040281). (ORPHA:2963)
- Thick eyebrow (HP:0000574): Increased density/number and/or increased diameter of eyebrow hairs. Evidence: TAS. Frequency: Very frequent (HP:0040281). (ORPHA:2963)
- Cutis laxa (HP:0000973): Wrinkled, redundant, inelastic and sagging skin. Evidence: TAS. Frequency: Very frequent (HP:0040281). (ORPHA:2963)
- Failure to thrive (HP:0001508): Failure to thrive (FTT) refers to a child whose physical growth is substantially below the norm. Evidence: TAS. Frequency: Very frequent (HP:0040281). (ORPHA:2963)
- Intrauterine growth retardation (HP:0001511): An abnormal restriction of fetal growth with fetal weight below the tenth percentile for gestational age. Evidence: TAS. Frequency: Very frequent (HP:0040281). (ORPHA:2963)
- Umbilical hernia (HP:0001537): Protrusion of abdominal contents through a defect in the abdominal wall musculature around the umbilicus. Skin and subcutaneous tissue overlie the defect. Evidence: TAS. Frequency: Very frequent (HP:0040281). (ORPHA:2963)
- Redundant skin (HP:0001582): Loose and sagging skin often associated with loss of skin elasticity. Evidence: TAS. Frequency: Very frequent (HP:0040281). (ORPHA:2963)
- Abnormal hair morphology (HP:0001595): An abnormality of the hair. Evidence: TAS. Frequency: Very frequent (HP:0040281). (ORPHA:2963)
- Abnormal nail morphology (HP:0001597): Abnormal structure or appearance of the nail. Evidence: TAS. Frequency: Very frequent (HP:0040281). (ORPHA:2963)
- Generalized hirsutism (HP:0002230): Abnormally increased hair growth over much of the entire body. Evidence: TAS. Frequency: Very frequent (HP:0040281). (ORPHA:2963)
- Brittle hair (HP:0002299): Fragile, easily breakable hair, i.e., with reduced tensile strength. Evidence: TAS. Frequency: Very frequent (HP:0040281). (ORPHA:2963)
- Reduced subcutaneous adipose tissue (HP:0003758): A reduced amount of fat tissue in the lowest layer of the integument. This feature can be appreciated by a reduced skinfold thickness. Evidence: TAS. Frequency: Very frequent (HP:0040281). (ORPHA:2963)
- Short stature (HP:0004322): A height below that which is expected according to age and gender norms. Although there is no universally accepted definition of short stature, many refer to "short stature" as height more than 2 standard deviations below the mean for age and gender (or below the 3rd percentile for age and gender dependent norms). Evidence: TAS. Frequency: Very frequent (HP:0040281). (ORPHA:2963)
- Decreased skull ossification (HP:0004331): A reduction in the magnitude or amount of ossification of the skull. Evidence: TAS. Frequency: Very frequent (HP:0040281). (ORPHA:2963)
- Abnormal dermatoglyphics (HP:0007477): An abnormality of dermatoglyphs (fingerprints), which are present on fingers, palms, toes, and soles. Evidence: TAS. Frequency: Very frequent (HP:0040281). (ORPHA:2963)
- Prematurely aged appearance (HP:0007495). Evidence: TAS. Frequency: Very frequent (HP:0040281). (ORPHA:2963)
- Long eyelashes in irregular rows (HP:0007740). Evidence: TAS. Frequency: Very frequent (HP:0040281). (ORPHA:2963)
- Sparse hair (HP:0008070): Reduced density of hairs. Evidence: TAS. Frequency: Very frequent (HP:0040281). (ORPHA:2963)
- Shagreen patch (HP:0009721): A plaque representing a connective-tissue nevus. Connective tissue naevi are uncommon skin lesions that occur when the deeper layers of the skin do not develop correctly or the components of these layers occur in the wrong proportion. Shagreen patches are oval-shaped and nevoid, skin-colored or occasionally pigmented, smooth or crinkled. The word shagreen refers to a type of roughened untanned leather. Evidence: TAS. Frequency: Very frequent (HP:0040281). (ORPHA:2963)
- Tooth agenesis (HP:0009804): The absence of one or more teeth from the normal series by a failure to develop. Evidence: TAS. Frequency: Very frequent (HP:0040281). (ORPHA:2963)
- Short distal phalanx of finger (HP:0009882): Short distance from the end of the finger to the most distal interphalangeal crease or the distal interphalangeal joint flexion point. That is, hypoplasia of one or more of the distal phalanx of finger. Evidence: TAS. Frequency: Very frequent (HP:0040281). (ORPHA:2963)
- Lipoatrophy (HP:0100578): Localized loss of fat tissue. Evidence: TAS. Frequency: Very frequent (HP:0040281). (ORPHA:2963)
- Posteriorly rotated ears (HP:0000358): A type of abnormal location of the ears in which the position of the ears is characterized by posterior rotation (the superior part of the ears is rotated towards the back of the head, and the inferior part of the ears towards the front). Evidence: TAS. Frequency: Very frequent (HP:0040281). (ORPHA:2963)